Phenotypes associated with the disease alopecia-intellectual disability syndrome 3 (OMIM:613930):
- Alopecia universalis (HP:0002289): Loss of all hair on the entire body. Evidence: TAS. (OMIM:613930)
- Congenital onset (HP:0003577): A phenotypic abnormality that is present at birth. Evidence: TAS. (OMIM:613930)
- Autosomal recessive inheritance (HP:0000007): A mode of inheritance that is observed for traits related to a gene encoded on one of the autosomes (i.e., the human chromosomes 1-22) in which a trait manifests in individuals with two pathogenic alleles, either homozygotes (two copies of the same mutant allele) or compound heterozygotes (whereby each copy of a gene has a distinct mutant allele). Evidence: TAS. (OMIM:613930)
- Severe intellectual disability (HP:0010864): Severe intellectual disability (ID) is defined as a type of ID characterized by severely sub-average adaptive functioning and intellectual functioning, with an intelligence quotient (IQ) the range of 20-34. Evidence: TAS. (OMIM:613930)